Phenotypes associated with the disease atrial fibrillation, familial, 1 (OMIM:608583):
- Thromboembolic stroke (HP:0001727): A cerebrovascular accident (stroke) that occurs because of thromboembolism. Evidence: PCS. Frequency: 2/10. (PMID:9070470)
- Childhood onset (HP:0011463): Onset of disease at the age of between 1 and 5 years. Evidence: PCS. (PMID:9070470)
- Adult onset (HP:0003581): Onset of disease manifestations in adulthood, defined here as at the age of 16 years or later. Evidence: PCS. (PMID:9070470)
- Atrial fibrillation (HP:0005110): An atrial arrhythmia characterized by disorganized atrial activity without discrete P waves on the surface EKG, but instead by an undulating baseline or more sharply circumscribed atrial deflections of varying amplitude an frequency ranging from 350 to 600 per minute. Evidence: PCS. (PMID:9070470)
- Autosomal dominant inheritance (HP:0000006): A mode of inheritance that is observed for traits related to a gene encoded on one of the autosomes (i.e., the human chromosomes 1-22) in which a trait manifests in heterozygotes. In the context of medical genetics, an autosomal dominant disorder is caused when a single copy of the mutant allele is present. Males and females are affected equally, and can both transmit the disorder with a risk of 50% for each child of inheriting the mutant allele. Evidence: PCS. (PMID:9070470)